- Hemangioma (HP:0001028): A hemangioma is a benign tumor characterized by blood-filled spaces lined by benign endothelial cells. A hemangioma characterized by large endothelial spaces (caverns) is called a cavernous hemangioma (in contrast to a hemangioma with small endothelial spaces, which is called capillary hemangioma). Evidence: TAS. Frequency: Very frequent (HP:0040281). (ORPHA:2330)
- Thrombocytopenia (HP:0001873): A reduction in the number of circulating thrombocytes. Evidence: TAS. Frequency: Very frequent (HP:0040281). (ORPHA:2330)
- Hypofibrinogenemia (HP:0011900): Decreased concentration of fibrinogen in the blood. Evidence: TAS. Frequency: Very frequent (HP:0040281). (ORPHA:2330)
- Petechiae (HP:0000967): Petechiae are pinpoint-sized reddish/purple spots, resembling a rash, that appear just under the skin or a mucous membrane when capillaries have ruptured and some superficial bleeding into the skin has happened. This term refers to an abnormally increased susceptibility to developing petechiae. Evidence: TAS. Frequency: Frequent (HP:0040282). (ORPHA:2330)
- Purpura (HP:0000979): Purpura (from Latin: purpura, meaning purple) is the appearance of red or purple discolorations on the skin that do not blanch on applying pressure. They are caused by bleeding underneath the skin. This term refers to an abnormally increased susceptibility to developing purpura. Purpura are larger than petechiae. Evidence: TAS. Frequency: Frequent (HP:0040282). (ORPHA:2330)
- Capillary hemangioma (HP:0005306): The presence of a capillary hemangioma, which are hemangiomas with small endothelial spaces. Evidence: TAS. Frequency: Frequent (HP:0040282). (ORPHA:2330)
- Tufted angioma (HP:0012329): A vascular tumor of the skin and subcutaneous tissues and characterized by slow angiomatous proliferation. Evidence: TAS. Frequency: Frequent (HP:0040282). (ORPHA:2330)
- Hyperhidrosis (HP:0000975): Abnormal excessive perspiration (sweating) despite the lack of appropriate stimuli like hot and humid weather. Evidence: TAS. Frequency: Occasional (HP:0040283). (ORPHA:2330)
- Decreased total neutrophil count (HP:0001875): Abnormal decrease of absolute number of neutrophils in the blood, per microlitre, compared to a reference range for a given sex and age-group. Evidence: TAS. Frequency: Occasional (HP:0040283). (ORPHA:2330)
- Decreased total leukocyte count (HP:0001882): An abnormal decreased number of leukocytes in the blood. Evidence: TAS. Frequency: Occasional (HP:0040283). (ORPHA:2330)
- Anemia (HP:0001903): A reduction in erythrocytes volume or hemoglobin concentration. Evidence: TAS. Frequency: Occasional (HP:0040283). (ORPHA:2330)
- Microangiopathic hemolytic anemia (HP:0001937). Evidence: TAS. Frequency: Occasional (HP:0040283). (ORPHA:2330)
- Chronic disseminated intravascular coagulation (HP:0005520): A chronic form of disseminated intravascular coagulation in which a persistent weak or intermittent activating stimulus is present and destruction and production of coagulation factors and platelets are balanced. Evidence: TAS. Frequency: Occasional (HP:0040283). (ORPHA:2330)
- Prolonged prothrombin time (HP:0008151): Increased time to coagulation in the prothrombin time test, which is a measure of the extrinsic pathway of coagulation. The results of the prothrombin time test are often expressed in terms of the International normalized ratio (INR), which is calculated as a ratio of the patient's prothrombin time (PT) to a control PT standardized for the potency of the thromboplastin reagent developed by the World Health Organization (WHO) using the formula: INR is equal to Patient PT divided by Control PT. Evidence: TAS. Frequency: Occasional (HP:0040283). (ORPHA:2330)
- Hepatic hemangioma (HP:0031207): A congenital vascular malformation in the liver composed of masses of blood vessels that are atypical or irregular in arrangement and size. Evidence: TAS. Frequency: Occasional (HP:0040283). (ORPHA:2330)
- Abnormal lymphatic vessel morphology (HP:0100766): A structural anomaly of the vessel that contains or conveys lymph fluid. Evidence: TAS. Frequency: Occasional (HP:0040283). (ORPHA:2330)
- Hypertrichosis (HP:0000998): Hypertrichosis is increased hair growth that is abnormal in quantity or location. Evidence: TAS. Frequency: Very rare (HP:0040284). (ORPHA:2330)
- Reticulocytosis (HP:0001923): An elevation in the number of reticulocytes (immature erythrocytes) in the peripheral blood circulation. Evidence: TAS. Frequency: Very rare (HP:0040284). (ORPHA:2330)
- Abdominal pain (HP:0002027): An unpleasant sensation characterized by physical discomfort (such as pricking, throbbing, or aching) and perceived to originate in the abdomen. Evidence: TAS. Frequency: Very rare (HP:0040284). (ORPHA:2330)
- Respiratory distress (HP:0002098): Respiratory distress is objectively observable as the physical or emotional consequences from the experience of dyspnea. The physical presentation of respiratory distress is generally referred to as labored breathing, while the sensation of respiratory distress is called shortness of breath or dyspnea. Evidence: TAS. Frequency: Very rare (HP:0040284). (ORPHA:2330)
- Abdominal distention (HP:0003270): Distention of the abdomen. Evidence: TAS. Frequency: Very rare (HP:0040284). (ORPHA:2330)
- Neoplasm of the skin (HP:0008069): A tumor (abnormal growth of tissue) of the skin. Evidence: TAS. Frequency: Very rare (HP:0040284). (ORPHA:2330)
- Hypopnea (HP:0040213): Hypopnea is referring to breathing that is abnormally shallow. Evidence: TAS. Frequency: Very rare (HP:0040284). (ORPHA:2330)
These phenotypes are associated with the disease Kasabach-Merritt phenomenon (ORPHA:2330).